- Upslanted palpebral fissure (HP:0000582): The palpebral fissure inclination is more than two standard deviations above the mean for age (objective); or, the inclination of the palpebral fissure is greater than typical for age. Evidence: PCS. Frequency: 1/4. (PMID:38154379)
- Sloping forehead (HP:0000340): Inclination of the anterior surface of the forehead from the vertical more than two standard deviations above the mean (objective); or apparently excessive posterior sloping of the forehead in a lateral view. Evidence: PCS. Frequency: 2/4. (PMID:38154379)
- Congenital onset (HP:0003577): A phenotypic abnormality that is present at birth. Evidence: PCS. Frequency: 4/4. (PMID:38154379)
- Long philtrum (HP:0000343): Distance between nasal base and midline upper lip vermilion border more than 2 SD above the mean. Alternatively, an apparently increased distance between nasal base and midline upper lip vermilion border. Evidence: PCS. Frequency: 4/4. (PMID:38154379)
- Short stature (HP:0004322): A height below that which is expected according to age and gender norms. Although there is no universally accepted definition of short stature, many refer to "short stature" as height more than 2 standard deviations below the mean for age and gender (or below the 3rd percentile for age and gender dependent norms). Evidence: PCS. Frequency: 3/4. (PMID:38154379)
- Motor delay (HP:0001270): A type of Developmental delay characterized by a delay in acquiring motor skills. Evidence: PCS. Frequency: 2/2. (PMID:38154379)
- Absent cupid's bow (HP:0010800): Lack of paramedian peaks and median notch of the upper lip vermilion. Evidence: PCS. Frequency: 1/4. (PMID:38154379)
- Smooth philtrum (HP:0000319): Flat skin surface, with no ridge formation in the central region of the upper lip between the nasal base and upper vermilion border. Evidence: PCS. Frequency: 4/4. (PMID:38154379)
- Dental crowding (HP:0000678): Changes in alignment of teeth in the dental arch. Evidence: PCS. Frequency: 1/4. (PMID:38154379)
- Thin upper lip vermilion (HP:0000219): Height of the vermilion of the upper lip in the midline more than 2 SD below the mean. Alternatively, an apparently reduced height of the vermilion of the upper lip in the frontal view (subjective). Evidence: PCS. Frequency: 4/4. (PMID:38154379)
- Postnatal growth retardation (HP:0008897): Slow or limited growth after birth. Evidence: PCS. Frequency: 3/4. (PMID:38154379)
- Clinodactyly (HP:0030084): An angulation of a digit at an interphalangeal joint in the plane of the palm (finger) or sole (toe). Evidence: PCS. Frequency: 4/4. (PMID:38154379)
- Low hanging columella (HP:0009765): Columella extending inferior to the level of the nasal base, when viewed from the side. Evidence: PCS. Frequency: 2/4. (PMID:38154379)
- High palate (HP:0000218): Height of the palate more than 2 SD above the mean (objective) or palatal height at the level of the first permanent molar more than twice the height of the teeth (subjective). Evidence: PCS. Frequency: 1/4. (PMID:38154379)
- Pachygyria (HP:0001302): Pachygyria is a malformation of cortical development with abnormally wide gyri with sulci 1,5-3 cm apart and abnormally thick cortex measuring more than 5 mm (radiological definition). See also neuropathological definitions for 2-, 3-, and 4-layered lissencephaly. Evidence: PCS. Frequency: 2/3. (PMID:38154379)
- Protruding ear (HP:0000411): Angle formed by the plane of the ear and the mastoid bone greater than the 97th centile for age (objective); or, outer edge of the helix more than 2 cm from the mastoid at the point of maximum distance (objective). Evidence: PCS. Frequency: 4/4. (PMID:38154379)
- Patent ductus arteriosus (HP:0001643): In utero, the ductus arteriosus (DA) serves to divert ventricular output away from the lungs and toward the placenta by connecting the main pulmonary artery to the descending aorta. A patent ductus arteriosus (PDA) in the first 3 days of life is a physiologic shunt in healthy term and preterm newborn infants, and normally is substantially closed within about 24 hours after bith and completely closed after about three weeks. Failure of physiologcal closure is referred to a persistent or patent ductus arteriosus (PDA). Depending on the degree of left-to-right shunting, PDA can have clinical consequences. Evidence: PCS. Frequency: 2/4. (PMID:38154379)
- Retrognathia (HP:0000278): An abnormality in which the mandible is mislocalised posteriorly. Evidence: PCS. Frequency: 2/4. (PMID:38154379)
- Intellectual disability (HP:0001249): The term intellectual disability or intellectual developmental disorder is used to describe significantly sub-average intellectual and adaptive functioning based on clinical assessment and as measured by individually administered, appropriately normed, standardized and validated tests of intellectual functioning and adaptive behavior, with onset during the developmental period from infancy through adolescence. Evidence: PCS. Frequency: 2/2. (PMID:38154379)
- Pulmonary artery stenosis (HP:0004415): An abnormal narrowing or constriction of the pulmonary artery, in the main pulmonary artery and/or in the left or right pulmonary artery branches. Evidence: PCS. Frequency: 1/4. (PMID:38154379)
- Highly arched eyebrow (HP:0002553): Increased height of the central portion of the eyebrow, forming a crescent, semicircular, or inverted U shape. Evidence: PCS. Frequency: 4/4. (PMID:38154379)
- Tracheoesophageal fistula (HP:0002575): An abnormal connection (fistula) between the esophagus and the trachea. Evidence: PCS. Frequency: 1/4. (PMID:38154379)
- Downslanted palpebral fissures (HP:0000494): The palpebral fissure inclination is more than two standard deviations below the mean. Evidence: PCS. Frequency: 1/4. (PMID:38154379)
- Delayed speech and language development (HP:0000750): A degree of language development that is significantly below the norm for a child of a specified age. Evidence: PCS. Frequency: 2/2. (PMID:38154379)
- Secundum atrial septal defect (HP:0001684): A kind of atrial septum defect arising from an enlarged foramen ovale, inadequate growth of the septum secundum, or excessive absorption of the septum primum. Evidence: PCS. Frequency: 1/4. (PMID:38154379)
- Feeding difficulties (HP:0011968): Impaired ability to eat related to problems gathering food and getting ready to suck, chew, or swallow it. Evidence: PCS. Frequency: 3/4. (PMID:38154379)
- Global developmental delay (HP:0001263): A delay in the achievement of motor or mental milestones in the domains of development of a child, including motor skills, speech and language, cognitive skills, and social and emotional skills. This term should only be used to describe children younger than five years of age. Evidence: PCS. Frequency: 2/2. (PMID:38154379)
- Broad 2nd toe (HP:0100040): A broad appearance of the second toe. Evidence: PCS. Frequency: 3/4. (PMID:38154379)
- Primary microcephaly (HP:0011451): Head circumference below 2 standard deviations below the mean for age and gender at birth. Evidence: PCS. Frequency: 4/4. (PMID:38154379)
- Prominent nasal bridge (HP:0000426): Anterior positioning of the nasal root in comparison to the usual positioning for age. Evidence: PCS. Frequency: 4/4. (PMID:38154379)
- Autosomal recessive inheritance (HP:0000007): A mode of inheritance that is observed for traits related to a gene encoded on one of the autosomes (i.e., the human chromosomes 1-22) in which a trait manifests in individuals with two pathogenic alleles, either homozygotes (two copies of the same mutant allele) or compound heterozygotes (whereby each copy of a gene has a distinct mutant allele). Evidence: PCS. (PMID:38154379)
- Syndactyly (HP:0001159): Webbing or fusion of the fingers or toes, involving soft parts only or including bone structure. Bony fusions are referred to as "bony" syndactyly if the fusion occurs in a radio-ulnar axis. Fusions of bones of the fingers or toes in a proximo-distal axis are referred to as "symphalangism". Evidence: PCS. Frequency: 1/4. (PMID:38154379)
- Intrauterine growth retardation (HP:0001511): An abnormal restriction of fetal growth with fetal weight below the tenth percentile for gestational age. Evidence: PCS. Frequency: 2/4. (PMID:38154379)
- Micrognathia (HP:0000347): Developmental hypoplasia of the mandible. Evidence: PCS. Frequency: 2/4. (PMID:38154379)
- Simplified gyral pattern (HP:0009879): An abnormality of the cerebral cortex with fewer gyri but with normal cortical thickness. This pattern is usually often associated with congenital microcephaly. Evidence: PCS. Frequency: 3/3. (PMID:38154379)
- Widely spaced teeth (HP:0000687): Increased spaces (diastemata) between most of the teeth in the same dental arch. Evidence: PCS. Frequency: 1/4. (PMID:38154379)
- Patent foramen ovale (HP:0001655): Failure of the foramen ovale to seal postnatally, leaving a potential conduit between the left and right cardiac atria. Evidence: PCS. Frequency: 1/4. (PMID:38154379)
These phenotypes are associated with the disease Seckel syndrome 11 (OMIM:620767).